Phenotypes associated with the disease intellectual disability, autosomal dominant 30 (OMIM:616083):
- Wide mouth (HP:0000154): Distance between the oral commissures more than 2 SD above the mean. Alternatively, an apparently increased width of the oral aperture (subjective). Evidence: PCS. Frequency: 2/7. (PMID:25217958)
- Overfolded helix (HP:0000396): A condition in which the helix is folded over to a greater degree than normal. That is, excessive curling of the helix edge, whereby the free edge is parallel to the plane of the ear. Evidence: PCS. Frequency: 1/7. (PMID:25217958)
- Bilateral tonic-clonic seizure (HP:0002069): A bilateral tonic-clonic seizure is a seizure defined by a tonic (bilateral increased tone, lasting seconds to minutes) and then a clonic (bilateral sustained rhythmic jerking) phase. Evidence: PCS. Frequency: 1/7. (PMID:25217958)
- Upslanted palpebral fissure (HP:0000582): The palpebral fissure inclination is more than two standard deviations above the mean for age (objective); or, the inclination of the palpebral fissure is greater than typical for age. Evidence: PCS. Frequency: 1/7. (PMID:25217958)
- Mild intellectual disability (HP:0001256): Mild intellectual disability (ID) is defined as a type of ID characterized by mildly sub-average adaptive functioning and intellectual functioning, with an intelligence quotient (IQ) the range of 50-69. Evidence: PCS. Frequency: 7/7. (PMID:25217958)
- Delayed speech and language development (HP:0000750): A degree of language development that is significantly below the norm for a child of a specified age. Evidence: PCS. Frequency: 6/7. (PMID:25217958)
- Global developmental delay (HP:0001263): A delay in the achievement of motor or mental milestones in the domains of development of a child, including motor skills, speech and language, cognitive skills, and social and emotional skills. This term should only be used to describe children younger than five years of age. Evidence: PCS. (PMID:25217958)
- Hypotonia (HP:0001252): Hypotonia is an abnormally low muscle tone (the amount of tension or resistance to movement in a muscle). Even when relaxed, muscles have a continuous and passive partial contraction which provides some resistance to passive stretching. Hypotonia thus manifests as diminished resistance to passive stretching. Hypotonia is not the same as muscle weakness, although the two conditions can co-exist. Evidence: PCS. Frequency: 5/6. (PMID:25217958)
- Infantile onset (HP:0003593): Onset of signs or symptoms of disease between 28 days to one year of life. Evidence: PCS. (PMID:25217958)
- Motor delay (HP:0001270): A type of Developmental delay characterized by a delay in acquiring motor skills. Evidence: PCS. Frequency: 5/5. (PMID:25217958)
- Reduced social responsiveness (HP:0012760): A reduced ability to participate in the back-and-forth flow of social interaction appropriate to culture and developmental level, which is normally characterized by an influence of the behavior of one person on the behavior of another person. This results in difficulty interacting with others through emotional, physical, or verbal communication. Evidence: PCS. Frequency: 5/7. (PMID:25217958)
- Aggressive behavior (HP:0000718): Behavior or an act aimed at harming a person, animal, or physical property (e.g., acts of physical violence; shouting, swearing, and using harsh language; slashing someone's tires). Evidence: PCS. Frequency: 3/7. (PMID:25217958)
- Ptosis (HP:0000508): The upper eyelid margin is positioned 3 mm or more lower than usual and covers the superior portion of the iris (objective); or, the upper lid margin obscures at least part of the pupil (subjective). Evidence: PCS. Frequency: 2/7. (PMID:25217958)
- Hypertelorism (HP:0000316): Interpupillary distance more than 2 SD above the mean (alternatively, the appearance of an increased interpupillary distance or widely spaced eyes). Evidence: PCS. Frequency: 1/7. (PMID:25217958)
- Synophrys (HP:0000664): Meeting of the medial eyebrows in the midline. Evidence: PCS. Frequency: 1/7. (PMID:25217958)
- Supernumerary nipple (HP:0002558): Presence of more than two nipples. Evidence: PCS. Frequency: 1/7. (PMID:25217958)
- Autosomal dominant inheritance (HP:0000006): A mode of inheritance that is observed for traits related to a gene encoded on one of the autosomes (i.e., the human chromosomes 1-22) in which a trait manifests in heterozygotes. In the context of medical genetics, an autosomal dominant disorder is caused when a single copy of the mutant allele is present. Males and females are affected equally, and can both transmit the disorder with a risk of 50% for each child of inheriting the mutant allele. Evidence: PCS. (PMID:25217958)
- Brachycephaly (HP:0000248): An abnormality of skull shape characterized by a decreased anterior-posterior diameter. That is, a cephalic index greater than 81%. Alternatively, an apparently shortened anteroposterior dimension (length) of the head compared to width. Evidence: PCS. Frequency: 1/7. (PMID:25217958)